Phenotypes associated with the disease microcephaly 11, primary, autosomal recessive (OMIM:615414):
- Microcephaly (HP:0000252): Head circumference below 2 standard deviations below the mean for age and gender. Evidence: PCS. Frequency: 2/2. (PMID:23418308)
- Short stature (HP:0004322): A height below that which is expected according to age and gender norms. Although there is no universally accepted definition of short stature, many refer to "short stature" as height more than 2 standard deviations below the mean for age and gender (or below the 3rd percentile for age and gender dependent norms). Evidence: PCS. Frequency: 2/2. (PMID:23418308)
- Autosomal recessive inheritance (HP:0000007): A mode of inheritance that is observed for traits related to a gene encoded on one of the autosomes (i.e., the human chromosomes 1-22) in which a trait manifests in individuals with two pathogenic alleles, either homozygotes (two copies of the same mutant allele) or compound heterozygotes (whereby each copy of a gene has a distinct mutant allele). Evidence: PCS. (PMID:23418308)